- Abnormality of the skeletal system (HP:0000924): An abnormality of the skeletal system. Evidence: IEA. (OMIM:189100)
- Autosomal dominant inheritance (HP:0000006): A mode of inheritance that is observed for traits related to a gene encoded on one of the autosomes (i.e., the human chromosomes 1-22) in which a trait manifests in heterozygotes. In the context of medical genetics, an autosomal dominant disorder is caused when a single copy of the mutant allele is present. Males and females are affected equally, and can both transmit the disorder with a risk of 50% for each child of inheriting the mutant allele. Evidence: TAS. (OMIM:189100)
These phenotypes are associated with the disease toe, misshapen (OMIM:189100).